- Autosomal dominant inheritance (HP:0000006): A mode of inheritance that is observed for traits related to a gene encoded on one of the autosomes (i.e., the human chromosomes 1-22) in which a trait manifests in heterozygotes. In the context of medical genetics, an autosomal dominant disorder is caused when a single copy of the mutant allele is present. Males and females are affected equally, and can both transmit the disorder with a risk of 50% for each child of inheriting the mutant allele. Evidence: IEA. (OMIM:191500)
- Hypersegmentation of neutrophil nuclei (HP:0004821): An excessive division of the lobes of the nucleus of a neutrophil. Evidence: IEA. (OMIM:191500)
These phenotypes are associated with the disease Undritz anomaly (OMIM:191500).